Phenotypes associated with the disease Osteochondritis dissecans (ORPHA:2764):
- Limitation of joint mobility (HP:0001376): A reduction in the freedom of movement of one or more joints. Evidence: TAS. Frequency: Very frequent (HP:0040281). (ORPHA:2764)
- Joint swelling (HP:0001386). Evidence: TAS. Frequency: Very frequent (HP:0040281). (ORPHA:2764)
- Joint stiffness (HP:0001387): Joint stiffness is a perceived sensation of tightness in a joint or joints when attempting to move them after a period of inactivity. Joint stiffness typically subsides over time. Evidence: TAS. Frequency: Very frequent (HP:0040281). (ORPHA:2764)
- Abnormality of the knee (HP:0002815): An abnormality of the knee joint or surrounding structures. Evidence: TAS. Frequency: Very frequent (HP:0040281). (ORPHA:2764)
- Arthralgia (HP:0002829): Joint pain. Evidence: TAS. Frequency: Very frequent (HP:0040281). (ORPHA:2764)
- Osteopenia (HP:0000938): Osteopenia is a term to define bone density that is not normal but also not as low as osteoporosis. By definition from the World Health Organization osteopenia is defined by bone densitometry as a T score -1 to -2.5. Evidence: TAS. Frequency: Frequent (HP:0040282). (ORPHA:2764)
- Abnormal joint morphology (HP:0001367): An abnormal structure or form of the joints, i.e., one or more of the articulations where two bones join. Evidence: TAS. Frequency: Frequent (HP:0040282). (ORPHA:2764)
- Limited elbow extension (HP:0001377): Limited ability to straighten the arm at the elbow joint. Evidence: TAS. Frequency: Frequent (HP:0040282). (ORPHA:2764)
- Joint hypermobility (HP:0001382): The capability that a joint (or a group of joints) has to move, passively and/or actively, beyond normal limits along physiological axes. Evidence: TAS. Frequency: Frequent (HP:0040282). (ORPHA:2764)
- Premature osteoarthritis (HP:0003088). Evidence: TAS. Frequency: Frequent (HP:0040282). (ORPHA:2764)
- Decreased hip abduction (HP:0003184): Reduced ability to move the femur outward to the side. Evidence: TAS. Frequency: Frequent (HP:0040282). (ORPHA:2764)
- Limited elbow flexion (HP:0006376). Evidence: TAS. Frequency: Frequent (HP:0040282). (ORPHA:2764)
- Avascular necrosis (HP:0010885): A disease where there is cellular death (necrosis) of bone components due to interruption of the blood supply. Evidence: TAS. Frequency: Frequent (HP:0040282). (ORPHA:2764)
- Abnormal musculoskeletal physiology (HP:0011843): An abnormality of the function of the skeletal system. Evidence: TAS. Frequency: Frequent (HP:0040282). (ORPHA:2764)
- Bone marrow edema (HP:6000917): Accumulation of excess fluid in the bone marrow. Evidence: TAS. Frequency: Frequent (HP:0040282). (ORPHA:2764)
- Gait disturbance (HP:0001288): The term gait disturbance can refer to any disruption of the ability to walk. Evidence: TAS. Frequency: Occasional (HP:0040283). (ORPHA:2764)
- Abnormal tibia morphology (HP:0002992): Abnormality of the tibia (shinbone). Evidence: TAS. Frequency: Occasional (HP:0040283). (ORPHA:2764)
- Quadriceps muscle atrophy (HP:0009050): Muscular atrophy involving the quadriceps muscle. Evidence: TAS. Frequency: Occasional (HP:0040283). (ORPHA:2764)